- Abnormality of metabolism/homeostasis (HP:0001939). Evidence: IEA. (OMIM:257150)
- Recurrent bacterial infections (HP:0002718): Increased susceptibility to bacterial infections as manifested by recurrent episodes of bacterial infection. Evidence: IEA. (OMIM:257150)
- Autosomal recessive inheritance (HP:0000007): A mode of inheritance that is observed for traits related to a gene encoded on one of the autosomes (i.e., the human chromosomes 1-22) in which a trait manifests in individuals with two pathogenic alleles, either homozygotes (two copies of the same mutant allele) or compound heterozygotes (whereby each copy of a gene has a distinct mutant allele). Evidence: IEA. (OMIM:257150)
These phenotypes are associated with the disease neutrophil actin dysfunction (OMIM:257150).